Phenotypes associated with the disease hereditary spastic paraplegia 48 (OMIM:613647):
- Progressive (HP:0003676): Applies to a disease manifestation that increases in scope or severity over the course of time, i.e., that worsens with age. Evidence: PCS. (PMID:24833714)
- Middle age onset (HP:0003596): A type of adult onset with onset of symptoms at the age of 40 to 60 years. Evidence: PCS. Frequency: 1/2. (PMID:24833714)
- Mild intellectual disability (HP:0001256): Mild intellectual disability (ID) is defined as a type of ID characterized by mildly sub-average adaptive functioning and intellectual functioning, with an intelligence quotient (IQ) the range of 50-69. Evidence: PCS. Frequency: 1/2. (PMID:24833714)
- Dysmetria (HP:0001310): A type of ataxia characterized by the inability to carry out movements with the correct range and motion across the plane of more than one joint related to incorrect estimation of the distances required for targeted movements. Evidence: PCS. Frequency: 1/2. (PMID:24833714)
- Urinary incontinence (HP:0000020): Loss of the ability to control the urinary bladder leading to involuntary urination. Evidence: PCS. Frequency: 1/2. (PMID:24833714)
- Spastic gait (HP:0002064): Spasticity is manifested by increased stretch reflex which is intensified with movement velocity. This results in excessive and inappropriate muscle activation which can contribute to muscle hypertonia. Spastic gait is characterized by manifestations such as muscle hypertonia, stiff knee, and circumduction of the leg. Evidence: TAS. (OMIM:613647)
- Periventricular white matter hyperintensities (HP:0030891): Areas of brighter than expected signal on magnetic resonance imaging emanating from the cerebral white matter that surrounds the cerebral ventricles. Evidence: PCS. Frequency: 1/2. (PMID:24833714)
- Infantile onset (HP:0003593): Onset of signs or symptoms of disease between 28 days to one year of life. Evidence: PCS. Frequency: 1/2. (PMID:24833714)
- Ataxia (HP:0001251): Ataxia refers to impaired coordination of voluntary muscle movement. Cerebellar ataxia refers to ataxia due to dysfunction of the cerebellum. This causes a variety of elementary neurological deficits including asynergy (lack of coordination between muscles, limbs and joints), dysmetria (lack of ability to judge distances that can lead to under- or overshoot in grasping movements), and dysdiadochokinesia (inability to perform rapid movements requiring antagonizing muscle groups to be switched on and off repeatedly). Evidence: TAS. (OMIM:613647)
- Lower limb spasticity (HP:0002061): Spasticity (velocity-dependent increase in tonic stretch reflexes with increased muscle tone and hyperexcitable tendon reflexes) in the muscles of the lower limbs, hips, and pelvis. Evidence: TAS. (OMIM:613647)
- Thin corpus callosum (HP:0033725): An abnormally thin corpus callous, due to atrophy, hypoplasia or agenesis. This term is intended to be used in situations where it is not known if thinning of the corpus callosum (for instance, as visualized by magnetic resonance tomography) is due to abnormal development (e.g. a leukodystrophy) or atrophy following normal development (e.g. neurodegeneration). Evidence: PCS. Frequency: 2/2. (PMID:24833714)
- Lower limb muscle weakness (HP:0007340): Weakness of the muscles of the legs. Evidence: TAS. (OMIM:613647)
- Mental deterioration (HP:0001268): Loss of previously present mental abilities, generally in adults. Evidence: TAS. (OMIM:613647)
- Spastic paraparesis (HP:0002313): Partial loss of the ability to move the lower limbs accompanied by spasticity of the lower limbs. Evidence: PCS. Frequency: 1/2. (PMID:24833714)
- Intellectual disability (HP:0001249): The term intellectual disability or intellectual developmental disorder is used to describe significantly sub-average intellectual and adaptive functioning based on clinical assessment and as measured by individually administered, appropriately normed, standardized and validated tests of intellectual functioning and adaptive behavior, with onset during the developmental period from infancy through adolescence. Evidence: IEA. (OMIM:613647)
- Broad-based gait (HP:0002136): An abnormal gait pattern in which persons stand and walk with their feet spaced widely apart. This is often a component of cerebellar ataxia. Evidence: PCS. Frequency: 1/2. (PMID:24833714)
- Parkinsonism (HP:0001300): Characteristic neurologic anomaly resulting from degeneration of dopamine-generating cells in the substantia nigra, a region of the midbrain, characterized clinically by shaking, rigidity, slowness of movement and difficulty with walking and gait. Evidence: TAS. (OMIM:613647)
- Hypoplasia of the corpus callosum (HP:0002079): Underdevelopment of the corpus callosum. Evidence: TAS. (OMIM:613647)
- Global developmental delay (HP:0001263): A delay in the achievement of motor or mental milestones in the domains of development of a child, including motor skills, speech and language, cognitive skills, and social and emotional skills. This term should only be used to describe children younger than five years of age. Evidence: PCS. Frequency: 1/2. (PMID:24833714)
- Peripheral neuropathy (HP:0009830): Peripheral neuropathy is a general term for any disorder of the peripheral nervous system. The main clinical features used to classify peripheral neuropathy are distribution, type (mainly demyelinating versus mainly axonal), duration, and course. Evidence: TAS. (OMIM:613647)
- Hyperintensity of cerebral white matter on MRI (HP:0030890): A brighter than expected signal on magnetic resonance imaging emanating from the cerebral white matter. Evidence: PCS. Frequency: 1/2. (PMID:24833714)
- Autosomal recessive inheritance (HP:0000007): A mode of inheritance that is observed for traits related to a gene encoded on one of the autosomes (i.e., the human chromosomes 1-22) in which a trait manifests in individuals with two pathogenic alleles, either homozygotes (two copies of the same mutant allele) or compound heterozygotes (whereby each copy of a gene has a distinct mutant allele). Evidence: PCS. (PMID:20613862)
- Tip-toe gait (HP:0030051): An abnormal gait pattern characterized by the failure of the heel to contact the floor at the onset of stance during gait. Evidence: PCS. Frequency: 1/2. (PMID:24833714)
- Spastic paraplegia (HP:0001258): Complete loss of the ability to move the lower limbs accompanied by spasticity of the lower limbs. Evidence: PCS. Frequency: 2/2. (PMID:24833714)
- Retinopathy (HP:0000488): Any noninflammatory disease of the retina. This nonspecific term is retained here because of its wide use in the literature, but if possible new annotations should indicate the precise type of retinal abnormality. Evidence: TAS. (OMIM:613647)